Phenotypes associated with the disease Pentasomy X syndrome (ORPHA:11):
- Delayed puberty (HP:0000823): Passing the age when puberty normally occurs with no physical or hormonal signs of the onset of puberty. Evidence: TAS. Frequency: Occasional (HP:0040283). (ORPHA:11)
- Hip dysplasia (HP:0001385): The presence of developmental dysplasia of the hip. Evidence: TAS. Frequency: Occasional (HP:0040283). (ORPHA:11)
- Patent ductus arteriosus (HP:0001643): In utero, the ductus arteriosus (DA) serves to divert ventricular output away from the lungs and toward the placenta by connecting the main pulmonary artery to the descending aorta. A patent ductus arteriosus (PDA) in the first 3 days of life is a physiologic shunt in healthy term and preterm newborn infants, and normally is substantially closed within about 24 hours after bith and completely closed after about three weeks. Failure of physiologcal closure is referred to a persistent or patent ductus arteriosus (PDA). Depending on the degree of left-to-right shunting, PDA can have clinical consequences. Evidence: TAS. Frequency: Occasional (HP:0040283). (ORPHA:11)
- Abnormal cardiac septum morphology (HP:0001671): An anomaly of the intra-atrial or intraventricular septum. Evidence: TAS. Frequency: Occasional (HP:0040283). (ORPHA:11)
- Abnormality of immune system physiology (HP:0010978): A functional abnormality of the immune system. Evidence: TAS. Frequency: Occasional (HP:0040283). (ORPHA:11)
- Hypotonia (HP:0001252): Hypotonia is an abnormally low muscle tone (the amount of tension or resistance to movement in a muscle). Even when relaxed, muscles have a continuous and passive partial contraction which provides some resistance to passive stretching. Hypotonia thus manifests as diminished resistance to passive stretching. Hypotonia is not the same as muscle weakness, although the two conditions can co-exist. Evidence: TAS. Frequency: Very frequent (HP:0040281). (ORPHA:11)
- Microcephaly (HP:0000252): Head circumference below 2 standard deviations below the mean for age and gender. Evidence: TAS. Frequency: Frequent (HP:0040282). (ORPHA:11)
- Hypertelorism (HP:0000316): Interpupillary distance more than 2 SD above the mean (alternatively, the appearance of an increased interpupillary distance or widely spaced eyes). Evidence: TAS. Frequency: Frequent (HP:0040282). (ORPHA:11)
- Micrognathia (HP:0000347): Developmental hypoplasia of the mandible. Evidence: TAS. Frequency: Frequent (HP:0040282). (ORPHA:11)
- Wide nasal bridge (HP:0000431): Increased breadth of the nasal bridge (and with it, the nasal root). Evidence: TAS. Frequency: Frequent (HP:0040282). (ORPHA:11)
- Strabismus (HP:0000486): A misalignment of the eyes so that the visual axes deviate from bifoveal fixation. The classification of strabismus may be based on a number of features including the relative position of the eyes, whether the deviation is latent or manifest, intermittent or constant, concomitant or otherwise and according to the age of onset and the relevance of any associated refractive error. Evidence: TAS. Frequency: Frequent (HP:0040282). (ORPHA:11)
- Upslanted palpebral fissure (HP:0000582): The palpebral fissure inclination is more than two standard deviations above the mean for age (objective); or, the inclination of the palpebral fissure is greater than typical for age. Evidence: TAS. Frequency: Frequent (HP:0040282). (ORPHA:11)
- Intellectual disability (HP:0001249): The term intellectual disability or intellectual developmental disorder is used to describe significantly sub-average intellectual and adaptive functioning based on clinical assessment and as measured by individually administered, appropriately normed, standardized and validated tests of intellectual functioning and adaptive behavior, with onset during the developmental period from infancy through adolescence. Evidence: TAS. Frequency: Frequent (HP:0040282). (ORPHA:11)
- Global developmental delay (HP:0001263): A delay in the achievement of motor or mental milestones in the domains of development of a child, including motor skills, speech and language, cognitive skills, and social and emotional skills. This term should only be used to describe children younger than five years of age. Evidence: TAS. Frequency: Frequent (HP:0040282). (ORPHA:11)
- Plagiocephaly (HP:0001357): Asymmetric head shape, which is usually a combination of unilateral occipital flattening with ipsilateral frontal prominence, leading to rhomboid cranial shape. Evidence: TAS. Frequency: Frequent (HP:0040282). (ORPHA:11)
- Short foot (HP:0001773): A measured foot length that is more than 2 SD below the mean for a newborn of 27 - 41 weeks gestation, or foot that is less than the 3rd centile for individuals from birth to 16 years of age (objective). Alternatively, a foot that appears disproportionately short (subjective). Evidence: TAS. Frequency: Frequent (HP:0040282). (ORPHA:11)
- Radioulnar synostosis (HP:0002974): An abnormal osseous union (fusion) between the radius and the ulna. Evidence: TAS. Frequency: Frequent (HP:0040282). (ORPHA:11)
- Clinodactyly of the 5th finger (HP:0004209): Clinodactyly refers to a bending or curvature of the fifth finger in the radial direction (i.e., towards the 4th finger). Evidence: TAS. Frequency: Frequent (HP:0040282). (ORPHA:11)
- Short stature (HP:0004322): A height below that which is expected according to age and gender norms. Although there is no universally accepted definition of short stature, many refer to "short stature" as height more than 2 standard deviations below the mean for age and gender (or below the 3rd percentile for age and gender dependent norms). Evidence: TAS. Frequency: Frequent (HP:0040282). (ORPHA:11)
- Camptodactyly of finger (HP:0100490): The distal interphalangeal joint and/or the proximal interphalangeal joint of the fingers cannot be extended to 180 degrees by either active or passive extension. Evidence: TAS. Frequency: Frequent (HP:0040282). (ORPHA:11)
- Small hand (HP:0200055): Disproportionately small hand. Evidence: TAS. Frequency: Frequent (HP:0040282). (ORPHA:11)
- Posteriorly rotated ears (HP:0000358): A type of abnormal location of the ears in which the position of the ears is characterized by posterior rotation (the superior part of the ears is rotated towards the back of the head, and the inferior part of the ears towards the front). Evidence: TAS. Frequency: Very frequent (HP:0040281). (ORPHA:11)